Phenotypes associated with the disease Usmani-Riazuddin syndrome, autosomal recessive (OMIM:619548):
- Epicanthus (HP:0000286): A fold of skin starting above the medial aspect of the upper eyelid and arching downward to cover, pass in front of and lateral to the medial canthus. Evidence: PCS. Frequency: 1/3. (PMID:34102099)
- Conjunctival hyperemia (HP:0030953): Dilatation of the blood vessels of the conjunctiva leading to a red appearance of the sclera. Evidence: PCS. Frequency: 1/3. (PMID:34102099)
- Delayed speech and language development (HP:0000750): A degree of language development that is significantly below the norm for a child of a specified age. Evidence: PCS. Frequency: 3/3. (PMID:34102099)
- Seizure (HP:0001250): A seizure is an intermittent abnormality of nervous system physiology characterized by a transient occurrence of signs and/or symptoms due to abnormal excessive or synchronous neuronal activity in the brain. Evidence: PCS. Frequency: 2/3. (PMID:34102099)
- Joint hypermobility (HP:0001382): The capability that a joint (or a group of joints) has to move, passively and/or actively, beyond normal limits along physiological axes. Evidence: PCS. Frequency: 2/3. (PMID:34102099)
- Agenesis of corpus callosum (HP:0001274): Absence of the corpus callosum as a result of the failure of the corpus callosum to develop, which can be the result of a failure in any one of the multiple steps of callosal development including cellular proliferation and migration, axonal growth or glial patterning at the midline. Evidence: PCS. Frequency: 1/3. (PMID:34102099)
- Global developmental delay (HP:0001263): A delay in the achievement of motor or mental milestones in the domains of development of a child, including motor skills, speech and language, cognitive skills, and social and emotional skills. This term should only be used to describe children younger than five years of age. Evidence: PCS. Frequency: 3/3. (PMID:34102099)
- Hypotonia (HP:0001252): Hypotonia is an abnormally low muscle tone (the amount of tension or resistance to movement in a muscle). Even when relaxed, muscles have a continuous and passive partial contraction which provides some resistance to passive stretching. Hypotonia thus manifests as diminished resistance to passive stretching. Hypotonia is not the same as muscle weakness, although the two conditions can co-exist. Evidence: PCS. Frequency: 3/3. (PMID:34102099)
- Aggressive behavior (HP:0000718): Behavior or an act aimed at harming a person, animal, or physical property (e.g., acts of physical violence; shouting, swearing, and using harsh language; slashing someone's tires). Evidence: PCS. Frequency: 2/3. (PMID:34102099)
- Hypertelorism (HP:0000316): Interpupillary distance more than 2 SD above the mean (alternatively, the appearance of an increased interpupillary distance or widely spaced eyes). Evidence: PCS. Frequency: 1/3. (PMID:34102099)
- Pectus excavatum (HP:0000767): A defect of the chest wall characterized by a depression of the sternum, giving the chest ("pectus") a caved-in ("excavatum") appearance. Evidence: PCS. Frequency: 1/3. (PMID:34102099)
- Autosomal recessive inheritance (HP:0000007): A mode of inheritance that is observed for traits related to a gene encoded on one of the autosomes (i.e., the human chromosomes 1-22) in which a trait manifests in individuals with two pathogenic alleles, either homozygotes (two copies of the same mutant allele) or compound heterozygotes (whereby each copy of a gene has a distinct mutant allele). Evidence: PCS. (PMID:34102099)
- High palate (HP:0000218): Height of the palate more than 2 SD above the mean (objective) or palatal height at the level of the first permanent molar more than twice the height of the teeth (subjective). Evidence: PCS. Frequency: 1/3. (PMID:34102099)
- Lumbar scoliosis (HP:0004626). Evidence: PCS. Frequency: 1/3. (PMID:34102099)
- Spasticity (HP:0001257): A motor disorder characterized by a velocity-dependent increase in tonic stretch reflexes with increased muscle tone, exaggerated (hyperexcitable) tendon reflexes. Evidence: PCS. Frequency: 3/3. (PMID:34102099)
- Intellectual disability (HP:0001249): The term intellectual disability or intellectual developmental disorder is used to describe significantly sub-average intellectual and adaptive functioning based on clinical assessment and as measured by individually administered, appropriately normed, standardized and validated tests of intellectual functioning and adaptive behavior, with onset during the developmental period from infancy through adolescence. Evidence: PCS. Frequency: 3/3. (PMID:34102099)
- Prominent supraorbital ridges (HP:0000336): Greater than average forward and/or lateral protrusion of the supraorbital portion of the frontal bones. Evidence: PCS. Frequency: 1/3. (PMID:34102099)
- Low-set ears (HP:0000369): Upper insertion of the ear to the scalp below an imaginary horizontal line drawn between the inner canthi of the eye and extending posteriorly to the ear. Evidence: PCS. Frequency: 1/3. (PMID:34102099)
- Posteriorly rotated ears (HP:0000358): A type of abnormal location of the ears in which the position of the ears is characterized by posterior rotation (the superior part of the ears is rotated towards the back of the head, and the inferior part of the ears towards the front). Evidence: PCS. Frequency: 1/3. (PMID:34102099)